- Anteverted nares (HP:0000463): Anteriorly-facing nostrils viewed with the head in the Frankfurt horizontal and the eyes of the observer level with the eyes of the subject. This gives the appearance of an upturned nose (upturned nasal tip). Evidence: TAS. Frequency: Very frequent (HP:0040281). (ORPHA:1969)
- Ptosis (HP:0000508): The upper eyelid margin is positioned 3 mm or more lower than usual and covers the superior portion of the iris (objective); or, the upper lid margin obscures at least part of the pupil (subjective). Evidence: TAS. Frequency: Very frequent (HP:0040281). (ORPHA:1969)
- Pectus excavatum (HP:0000767): A defect of the chest wall characterized by a depression of the sternum, giving the chest ("pectus") a caved-in ("excavatum") appearance. Evidence: TAS. Frequency: Frequent (HP:0040282). (ORPHA:1969)
- Abnormality of the thyroid gland (HP:0000820): An abnormality of the thyroid gland. Evidence: TAS. Frequency: Frequent (HP:0040282). (ORPHA:1969)
- Melanocytic nevus (HP:0000995): A oval and round, colored (usually medium-to dark brown, reddish brown, or flesh colored) lesion. Typically, a melanocytic nevus is less than 6 mm in diameter, but may be much smaller or larger. Evidence: TAS. Frequency: Frequent (HP:0040282). (ORPHA:1969)
- Asymmetry of the thorax (HP:0001555): Lack of symmetry between the left and right halves of the thorax. Evidence: TAS. Frequency: Frequent (HP:0040282). (ORPHA:1969)
- Abnormality of the voice (HP:0001608). Evidence: TAS. Frequency: Frequent (HP:0040282). (ORPHA:1969)
- Abnormal mitral valve morphology (HP:0001633): Any structural anomaly of the mitral valve. Evidence: TAS. Frequency: Occasional (HP:0040283). (ORPHA:1969)
- Anorexia (HP:0002039): Lack of desire to eat (loss of appetite). Evidence: TAS. Frequency: Very frequent (HP:0040281). (ORPHA:1969)
- Scoliosis (HP:0002650): The presence of an abnormal lateral curvature of the spine. Evidence: TAS. Frequency: Frequent (HP:0040282). (ORPHA:1969)
- Kyphosis (HP:0002808): Exaggerated anterior convexity of the thoracic vertebral column. Evidence: TAS. Frequency: Frequent (HP:0040282). (ORPHA:1969)
- Genu varum (HP:0002970): A positional abnormality marked by outward bowing of the legs in which the knees stay wide apart when a person stands with the feet and ankles together. Evidence: TAS. Frequency: Very frequent (HP:0040281). (ORPHA:1969)
- Skeletal muscle atrophy (HP:0003202): The presence of skeletal muscular atrophy (which is also known as amyotrophy). Evidence: TAS. Frequency: Frequent (HP:0040282). (ORPHA:1969)
- Midline defect of the nose (HP:0004122): This term groups together three conditions that presumably represent different degrees of severity of a midline defect of the nose or nasal tip. Evidence: TAS. Frequency: Very frequent (HP:0040281). (ORPHA:1969)
- Short stature (HP:0004322): A height below that which is expected according to age and gender norms. Although there is no universally accepted definition of short stature, many refer to "short stature" as height more than 2 standard deviations below the mean for age and gender (or below the 3rd percentile for age and gender dependent norms). Evidence: TAS. Frequency: Very frequent (HP:0040281). (ORPHA:1969)
- Cachexia (HP:0004326): Severe weight loss, wasting of muscle, loss of appetite, and general debility related to a chronic disease. Evidence: TAS. Frequency: Very frequent (HP:0040281). (ORPHA:1969)
- Finger syndactyly (HP:0006101): Webbing or fusion of the fingers, involving soft parts only or including bone structure. Bony fusions are referred to as "bony" Syndactyly if the fusion occurs in a radio-ulnar axis. Fusions of bones of the fingers in a proximo-distal axis are referred to as "Symphalangism". Evidence: TAS. Frequency: Very frequent (HP:0040281). (ORPHA:1969)
- Generalized hypopigmentation (HP:0007513). Evidence: TAS. Frequency: Occasional (HP:0040283). (ORPHA:1969)
- Multiple cafe-au-lait spots (HP:0007565): The presence of six or more cafe-au-lait spots. Evidence: TAS. Frequency: Frequent (HP:0040282). (ORPHA:1969)
- Abnormal retinal pigmentation (HP:0007703): Any deviation from the normal pigmentation of the retina. Evidence: TAS. Frequency: Frequent (HP:0040282). (ORPHA:1969)
- Short hard palate (HP:0010290): Distance between the labial point of the incisive papilla to the midline junction of the hard and soft palate more than 2 SD below the mean (objective) or apparently decreased length of the hard palate (subjective). Evidence: TAS. Frequency: Frequent (HP:0040282). (ORPHA:1969)
These phenotypes are associated with the disease Facial dysmorphism-anorexia-cachexia-eye and skin anomalies syndrome (ORPHA:1969).